Phenotypes associated with the disease Prieto syndrome (OMIM:309610):
- Epicanthus (HP:0000286): A fold of skin starting above the medial aspect of the upper eyelid and arching downward to cover, pass in front of and lateral to the medial canthus. Evidence: IEA. (OMIM:309610)
- Abnormality of the dentition (HP:0000164): Any abnormality of the teeth. Evidence: IEA. (OMIM:309610)
- Strabismus (HP:0000486): A misalignment of the eyes so that the visual axes deviate from bifoveal fixation. The classification of strabismus may be based on a number of features including the relative position of the eyes, whether the deviation is latent or manifest, intermittent or constant, concomitant or otherwise and according to the age of onset and the relevance of any associated refractive error. Evidence: IEA. (OMIM:309610)
- Inguinal hernia (HP:0000023): Protrusion of the contents of the abdominal cavity through the inguinal canal. Evidence: IEA. (OMIM:309610)
- Hypotonia (HP:0001252): Hypotonia is an abnormally low muscle tone (the amount of tension or resistance to movement in a muscle). Even when relaxed, muscles have a continuous and passive partial contraction which provides some resistance to passive stretching. Hypotonia thus manifests as diminished resistance to passive stretching. Hypotonia is not the same as muscle weakness, although the two conditions can co-exist. Evidence: IEA. (OMIM:309610)
- Generalized hypotonia (HP:0001290): Generalized muscular hypotonia (abnormally low muscle tone). Evidence: TAS. (OMIM:309610)
- Osteoporosis (HP:0000939): Osteoporosis is a systemic skeletal disease characterized by low bone density and microarchitectural deterioration of bone tissue with a consequent increase in bone fragility. According to the WHO criteria, osteoporosis is defined as a BMD that lies 2.5 standard deviations or more below the average value for young healthy adults (a T-score below -2.5 SD). Evidence: IEA. (OMIM:309610)
- Nystagmus (HP:0000639): Rhythmic, involuntary oscillations of one or both eyes related to abnormality in fixation, conjugate gaze, or vestibular mechanisms. Evidence: IEA. (OMIM:309610)
- Hypertelorism (HP:0000316): Interpupillary distance more than 2 SD above the mean (alternatively, the appearance of an increased interpupillary distance or widely spaced eyes). Evidence: IEA. (OMIM:309610)
- Radial deviation of finger (HP:0009466): Bending or curvature of a finger toward the radial side (i.e., towards the thumb). The deviation is at the metacarpal-phalangeal joint, and this finding is distinct from clinodactyly. Evidence: IEA. (OMIM:309610)
- Patellar dislocation (HP:0002999): The kneecap normally is located within the groove termed trochlea on the distal femur and can slide up and down in it. Patellar dislocation occurs if the patella fully dislocates out of the groove. Evidence: PCS. (PMID:3121220)
- 11 pairs of ribs (HP:0000878): Presence of only 11 pairs of ribs. Evidence: IEA. (OMIM:309610)
- Clinodactyly (HP:0030084): An angulation of a digit at an interphalangeal joint in the plane of the palm (finger) or sole (toe). Evidence: PCS. (PMID:3121220)
- Retrognathia (HP:0000278): An abnormality in which the mandible is mislocalised posteriorly. Evidence: IEA. (OMIM:309610)
- Intellectual disability (HP:0001249): The term intellectual disability or intellectual developmental disorder is used to describe significantly sub-average intellectual and adaptive functioning based on clinical assessment and as measured by individually administered, appropriately normed, standardized and validated tests of intellectual functioning and adaptive behavior, with onset during the developmental period from infancy through adolescence. Evidence: IEA. (OMIM:309610)
- Cerebral atrophy (HP:0002059): Atrophy (wasting, decrease in size of cells or tissue) affecting the cerebrum. Evidence: IEA. (OMIM:309610)
- Talipes equinovarus (HP:0001762): Talipes equinovarus (also called clubfoot) typically has four main components: inversion and adduction of the forefoot; inversion of the heel and hindfoot; equinus (limitation of extension) of the ankle and subtalar joint; and internal rotation of the leg. Evidence: IEA. (OMIM:309610)
- Coxa valga (HP:0002673): Coxa valga is a deformity of the hip in which the angle between the femoral shaft and the femoral neck is increased compared to age-adjusted values (about 150 degrees in newborns gradually reducing to 120-130 degrees in adults). Evidence: IEA. (OMIM:309610)
- Patellar subluxation (HP:0010499): The kneecap normally is located within the groove termed trochlea on the distal femur and can slide up and down in it. Patellar subluxation refers to an unstable kneecap that does not slide centrally within its groove, i.e., a partial dislocation of the patella. Evidence: IEA. (OMIM:309610)
- X-linked recessive inheritance (HP:0001419): A mode of inheritance that is observed for recessive traits related to a gene encoded on the X chromosome. In the context of medical genetics, X-linked recessive disorders manifest in males (who have one copy of the X chromosome and are thus hemizygotes), but generally not in female heterozygotes who have one mutant and one normal allele. Evidence: PCS. (PMID:3121220)
- Skin dimple (HP:0010781): Skin dimples are cutaneous indentations that are the result of tethering of the skin to underlying structures (bone) causing an indentation. Evidence: PCS. (PMID:3121220)
- Ptosis (HP:0000508): The upper eyelid margin is positioned 3 mm or more lower than usual and covers the superior portion of the iris (objective); or, the upper lid margin obscures at least part of the pupil (subjective). Evidence: IEA. (OMIM:309610)
- Prominent nose (HP:0000448): Distance between subnasale and pronasale more than two standard deviations above the mean, or alternatively, an apparently increased anterior protrusion of the nasal tip. Evidence: IEA. (OMIM:309610)
- High forehead (HP:0000348): An abnormally increased height of the forehead. Evidence: IEA. (OMIM:309610)
- Cryptorchidism (HP:0000028): Testis in inguinal canal. That is, absence of one or both testes from the scrotum owing to failure of the testis or testes to descend through the inguinal canal to the scrotum. Evidence: IEA. (OMIM:309610)
- Low-set ears (HP:0000369): Upper insertion of the ear to the scalp below an imaginary horizontal line drawn between the inner canthi of the eye and extending posteriorly to the ear. Evidence: IEA. (OMIM:309610)